- Cryptorchidism (HP:0000028): Testis in inguinal canal. That is, absence of one or both testes from the scrotum owing to failure of the testis or testes to descend through the inguinal canal to the scrotum. Evidence: TAS. Frequency: Very frequent (HP:0040281). (ORPHA:3255)
- Microcephaly (HP:0000252): Head circumference below 2 standard deviations below the mean for age and gender. Evidence: TAS. Frequency: Very frequent (HP:0040281). (ORPHA:3255)
- Prominent nasal bridge (HP:0000426): Anterior positioning of the nasal root in comparison to the usual positioning for age. Evidence: TAS. Frequency: Very frequent (HP:0040281). (ORPHA:3255)
- Underdeveloped nasal alae (HP:0000430): Thinned, deficient, or excessively arched ala nasi. Evidence: TAS. Frequency: Very frequent (HP:0040281). (ORPHA:3255)
- Wide nasal bridge (HP:0000431): Increased breadth of the nasal bridge (and with it, the nasal root). Evidence: TAS. Frequency: Very frequent (HP:0040281). (ORPHA:3255)
- Wide nose (HP:0000445): Interalar distance more than two standard deviations above the mean for age, i.e., an apparently increased width of the nasal base and alae. Evidence: TAS. Frequency: Very frequent (HP:0040281). (ORPHA:3255)
- Intellectual disability (HP:0001249): The term intellectual disability or intellectual developmental disorder is used to describe significantly sub-average intellectual and adaptive functioning based on clinical assessment and as measured by individually administered, appropriately normed, standardized and validated tests of intellectual functioning and adaptive behavior, with onset during the developmental period from infancy through adolescence. Evidence: TAS. Frequency: Very frequent (HP:0040281). (ORPHA:3255)
- Global developmental delay (HP:0001263): A delay in the achievement of motor or mental milestones in the domains of development of a child, including motor skills, speech and language, cognitive skills, and social and emotional skills. This term should only be used to describe children younger than five years of age. Evidence: TAS. Frequency: Very frequent (HP:0040281). (ORPHA:3255)
- Specific learning disability (HP:0001328): Impairment of certain skills such as reading or writing, coordination, self-control, or attention that interfere with the ability to learn. The impairment is not related to a global deficiency of intelligence. Evidence: TAS. Frequency: Very frequent (HP:0040281). (ORPHA:3255)
- Mutism (HP:0002300): Complete lack of speech or verbal communication in a person despite attempts to engage in conversation. Mutism as a phenomena assumes the individual has previous capacity for speech and in the pediatric population it assumes that the person is past the age of typical language development. Evidence: TAS. Frequency: Very frequent (HP:0040281). (ORPHA:3255)
- Aphasia (HP:0002381): An acquired language impairment of some or all of the abilities to produce or comprehend speech and to read or write. Evidence: TAS. Frequency: Very frequent (HP:0040281). (ORPHA:3255)
- Severe short stature (HP:0003510): A severe degree of short stature, more than -4 SD from the mean corrected for age and sex. Evidence: TAS. Frequency: Very frequent (HP:0040281). (ORPHA:3255)
- Clinodactyly of the 5th finger (HP:0004209): Clinodactyly refers to a bending or curvature of the fifth finger in the radial direction (i.e., towards the 4th finger). Evidence: TAS. Frequency: Very frequent (HP:0040281). (ORPHA:3255)
- Echolalia (HP:0010529): Echolalia is the automatic imitative repetition of sounds, words, or phrases in the absence of explicit awareness. The repeated words or phrases are typically odd or used in a non-social manner. These can be words or phrases that the affected individual has heard or invented. Evidence: TAS. Frequency: Very frequent (HP:0040281). (ORPHA:3255)
- Short philtrum (HP:0000322): Distance between nasal base and midline upper lip vermilion border more than 2 SD below the mean. Alternatively, an apparently decreased distance between nasal base and midline upper lip vermilion border. Evidence: TAS. Frequency: Frequent (HP:0040282). (ORPHA:3255)
- Broad forehead (HP:0000337): Width of the forehead or distance between the frontotemporales is more than two standard deviations above the mean (objective); or apparently increased distance between the two sides of the forehead. Evidence: TAS. Frequency: Frequent (HP:0040282). (ORPHA:3255)
- Downslanted palpebral fissures (HP:0000494): The palpebral fissure inclination is more than two standard deviations below the mean. Evidence: TAS. Frequency: Frequent (HP:0040282). (ORPHA:3255)
- Optic atrophy (HP:0000648): Atrophy of the optic nerve. Optic atrophy results from the death of the retinal ganglion cell axons that comprise the optic nerve and manifesting as a pale optic nerve on fundoscopy. Evidence: TAS. Frequency: Frequent (HP:0040282). (ORPHA:3255)
- Hypotonia (HP:0001252): Hypotonia is an abnormally low muscle tone (the amount of tension or resistance to movement in a muscle). Even when relaxed, muscles have a continuous and passive partial contraction which provides some resistance to passive stretching. Hypotonia thus manifests as diminished resistance to passive stretching. Hypotonia is not the same as muscle weakness, although the two conditions can co-exist. Evidence: TAS. Frequency: Frequent (HP:0040282). (ORPHA:3255)
- Spasticity (HP:0001257): A motor disorder characterized by a velocity-dependent increase in tonic stretch reflexes with increased muscle tone, exaggerated (hyperexcitable) tendon reflexes. Evidence: TAS. Frequency: Frequent (HP:0040282). (ORPHA:3255)
- Limitation of joint mobility (HP:0001376): A reduction in the freedom of movement of one or more joints. Evidence: TAS. Frequency: Frequent (HP:0040282). (ORPHA:3255)
- Growth delay (HP:0001510): A deficiency or slowing down of growth pre- and postnatally. Evidence: TAS. Frequency: Frequent (HP:0040282). (ORPHA:3255)
- Intrauterine growth retardation (HP:0001511): An abnormal restriction of fetal growth with fetal weight below the tenth percentile for gestational age. Evidence: TAS. Frequency: Frequent (HP:0040282). (ORPHA:3255)
- Small nail (HP:0001792): A nail that is diminished in length and width, i.e., underdeveloped nail. Evidence: TAS. Frequency: Frequent (HP:0040282). (ORPHA:3255)
- Clinodactyly of the 5th toe (HP:0001864): Bending or curvature of a fifth toe in the tibial direction (i.e., towards the big toe). Evidence: TAS. Frequency: Frequent (HP:0040282). (ORPHA:3255)
- Frontal bossing (HP:0002007): Bilateral bulging of the lateral frontal bone prominences with relative sparing of the midline. Evidence: TAS. Frequency: Frequent (HP:0040282). (ORPHA:3255)
- Limb dystonia (HP:0002451): A type of dystonia (abnormally increased muscular tone causing fixed abnormal postures) that affects muscles of the limbs. Evidence: TAS. Frequency: Frequent (HP:0040282). (ORPHA:3255)
- Delayed skeletal maturation (HP:0002750): A decreased rate of skeletal maturation. Delayed skeletal maturation can be diagnosed on the basis of an estimation of the bone age from radiographs of specific bones in the human body. Evidence: TAS. Frequency: Frequent (HP:0040282). (ORPHA:3255)
- Short stature (HP:0004322): A height below that which is expected according to age and gender norms. Although there is no universally accepted definition of short stature, many refer to "short stature" as height more than 2 standard deviations below the mean for age and gender (or below the 3rd percentile for age and gender dependent norms). Evidence: TAS. Frequency: Frequent (HP:0040282). (ORPHA:3255)
- Bilateral single transverse palmar creases (HP:0007598): The distal and proximal transverse palmar creases are merged into a single transverse palmar crease on both hands. Evidence: TAS. Frequency: Frequent (HP:0040282). (ORPHA:3255)
- Paraplegia (HP:0010550): Severe or complete weakness of both lower extremities with sparing of the upper extremities. Evidence: TAS. Frequency: Frequent (HP:0040282). (ORPHA:3255)
- Enlarged epiphyses (HP:0010580): Increased size of epiphyses. Evidence: TAS. Frequency: Frequent (HP:0040282). (ORPHA:3255)
- Aplastic/hypoplastic toenail (HP:0010624): Absence or underdevelopment of the toenail. Evidence: TAS. Frequency: Frequent (HP:0040282). (ORPHA:3255)
- Broad columella (HP:0010761): Increased width of the columella. Evidence: TAS. Frequency: Frequent (HP:0040282). (ORPHA:3255)
- Prominent forehead (HP:0011220): Forward prominence of the entire forehead, due to protrusion of the frontal bone. Evidence: TAS. Frequency: Frequent (HP:0040282). (ORPHA:3255)
- Thin vermilion border (HP:0000233): Height of the vermilion of the medial part of the lip more than 2 SD below the mean, or apparently reduced height of the vermilion of the lip in the frontal view. The vermilion is the red part of the lips (and confusingly, the vermilion itself is also often referred to as being equivalent the lips). Evidence: TAS. Frequency: Occasional (HP:0040283). (ORPHA:3255)
- Seizure (HP:0001250): A seizure is an intermittent abnormality of nervous system physiology characterized by a transient occurrence of signs and/or symptoms due to abnormal excessive or synchronous neuronal activity in the brain. Evidence: TAS. Frequency: Occasional (HP:0040283). (ORPHA:3255)
- Ventricular septal defect (HP:0001629): A hole between the two bottom chambers (ventricles) of the heart. The defect is centered around the most superior aspect of the ventricular septum. Evidence: TAS. Frequency: Occasional (HP:0040283). (ORPHA:3255)
- Supernumerary nipple (HP:0002558): Presence of more than two nipples. Evidence: TAS. Frequency: Occasional (HP:0040283). (ORPHA:3255)
- Finger syndactyly (HP:0006101): Webbing or fusion of the fingers, involving soft parts only or including bone structure. Bony fusions are referred to as "bony" Syndactyly if the fusion occurs in a radio-ulnar axis. Fusions of bones of the fingers in a proximo-distal axis are referred to as "Symphalangism". Evidence: TAS. Frequency: Occasional (HP:0040283). (ORPHA:3255)
These phenotypes are associated with the disease Filippi syndrome (ORPHA:3255).